- Patchy palmoplantar hyperkeratosis (HP:0005588): A focal type of palmoplantar keratoderma in which only certain areas of the palms and soles are affected. Evidence: TAS. Frequency: Very frequent (HP:0040281). (ORPHA:79141)
- Pain (HP:0012531): An unpleasant sensory and emotional experience associated with actual or potential tissue damage, or described in terms of such damage. Evidence: TAS. Frequency: Very frequent (HP:0040281). (ORPHA:79141)
These phenotypes are associated with the disease Hereditary painful callosities (ORPHA:79141).